- Hearing impairment (HP:0000365): A decreased magnitude of the sensory perception of sound. Evidence: IEA. (OMIM:156000)
- Vertigo (HP:0002321): An abnormal sensation of spinning while the body is actually stationary. Evidence: IEA. (OMIM:156000)
- Tinnitus (HP:0000360): Tinnitus is an auditory perception that can be described as the experience of sound, in the ear or in the head, in the absence of external acoustic stimulation. Evidence: TAS. (OMIM:156000)
- Typified by incomplete penetrance (HP:0003829): Description of conditions in which not all individuals with a given genotype exhibit the disease. Penetrance is the proportion that develop disease given a lifespan of 80 years. Evidence: TAS. (OMIM:156000)
- Autosomal dominant inheritance (HP:0000006): A mode of inheritance that is observed for traits related to a gene encoded on one of the autosomes (i.e., the human chromosomes 1-22) in which a trait manifests in heterozygotes. In the context of medical genetics, an autosomal dominant disorder is caused when a single copy of the mutant allele is present. Males and females are affected equally, and can both transmit the disorder with a risk of 50% for each child of inheriting the mutant allele. Evidence: IEA. (OMIM:156000)
These phenotypes are associated with the disease Meniere disease (OMIM:156000).